- Ptosis (HP:0000508): The upper eyelid margin is positioned 3 mm or more lower than usual and covers the superior portion of the iris (objective); or, the upper lid margin obscures at least part of the pupil (subjective). Evidence: TAS. Frequency: Occasional (HP:0040283). (ORPHA:91349)
- Blindness (HP:0000618): Blindness is the condition of lacking visual perception defined as a profound reduction in visual perception. On the 6m visual acuity scale, blindness is defined as less than 3/60. On the 20ft visual acuity scale, blindness is defined as less than 20/400. On the decimal visual acuity scale, blindness is defined as less than 0.05. Blindness is typically characterized by a visual field of no greater than 10 degrees in radius around central fixation. Evidence: TAS. Frequency: Occasional (HP:0040283). (ORPHA:91349)
- Diplopia (HP:0000651): Diplopia is a condition in which a single object is perceived as two images, it is also known as double vision. Evidence: TAS. Frequency: Occasional (HP:0040283). (ORPHA:91349)
- Central diabetes insipidus (HP:0000863): A form of diabetes insipidus related to a failure of vasopressin (AVP) release from the hypothalamus. Evidence: TAS. Frequency: Occasional (HP:0040283). (ORPHA:91349)
- Increased circulating prolactin concentration (HP:0000870): The presence of abnormally increased levels of prolactin in the blood. Prolactin is a peptide hormone produced by the anterior pituitary gland that plays a role in breast development and lactation during pregnancy. Evidence: TAS. Frequency: Occasional (HP:0040283). (ORPHA:91349)
- Panhypopituitarism (HP:0000871): A pituitary functional deficit affecting all the anterior pituitary hormones (growth hormone, thyroid-stimulating hormone, follicle-stimulating hormone, luteinizing hormone, adrenocorticotropic hormone, and prolactin). Evidence: TAS. Frequency: Occasional (HP:0040283). (ORPHA:91349)
- Diabetes insipidus (HP:0000873): A state of excessive water intake and hypotonic (dilute) polyuria. Diabetes insipidus may be due to failure of vasopressin (AVP) release (central or neurogenic diabetes insipidus) or to a failure of the kidney to respond to AVP (nephrogenic diabetes insipidus). Evidence: TAS. Frequency: Occasional (HP:0040283). (ORPHA:91349)
- Sudden loss of visual acuity (HP:0001117): Severe loss of visual acuity within hours or days. This is characteristic of Leber hereditary optic neuropathy. Evidence: TAS. Frequency: Occasional (HP:0040283). (ORPHA:91349)
- Seizure (HP:0001250): A seizure is an intermittent abnormality of nervous system physiology characterized by a transient occurrence of signs and/or symptoms due to abnormal excessive or synchronous neuronal activity in the brain. Evidence: TAS. Frequency: Occasional (HP:0040283). (ORPHA:91349)
- Macroorchidism, postpubertal (HP:0002050). Evidence: TAS. Frequency: Occasional (HP:0040283). (ORPHA:91349)
- Vertigo (HP:0002321): An abnormal sensation of spinning while the body is actually stationary. Evidence: TAS. Frequency: Occasional (HP:0040283). (ORPHA:91349)
- Cranial nerve paralysis (HP:0006824). Evidence: TAS. Frequency: Occasional (HP:0040283). (ORPHA:91349)
- Abducens palsy (HP:0006897): Malfunction of the abducens nerve as manifested by impairment of the ability of the affected eye to be moved outward. Patients who develop abducens nerve palsy often present with binocular horizontal diplopia, which is a double vision when looking at objects side by side. There will be a notable weakness of the ipsilateral lateral rectus muscle leading to a deficit in of eye abduction on the affected side. Some patients may present with a constant head turning movement to maintain binocular fusion and to lessen the degree of diplopia. Evidence: TAS. Frequency: Occasional (HP:0040283). (ORPHA:91349)
- Fourth cranial nerve palsy (HP:0007011): Paralysis of the fourth cranial (trochlear) nerve manifested as weakness of the superior oblique muscle which causes vertical diplopia that is maximal when the affected eye is adducted and directed inferiorly. Evidence: TAS. Frequency: Occasional (HP:0040283). (ORPHA:91349)
- Internal ophthalmoplegia (HP:0007942): Paralysis of the iris and ciliary apparatus. Evidence: TAS. Frequency: Occasional (HP:0040283). (ORPHA:91349)
- Oculomotor nerve palsy (HP:0012246): Reduced ability to control the movement of the eye associated with damage to the third cranial nerve (the oculomotor nerve). Evidence: TAS. Frequency: Occasional (HP:0040283). (ORPHA:91349)
- Hemianopia (HP:0012377): Partial or complete loss of vision in one half of the visual field of one or both eyes. Evidence: TAS. Frequency: Occasional (HP:0040283). (ORPHA:91349)
- Increased serum testosterone level (HP:0030088): An elevated circulating testosterone level in the blood. Evidence: TAS. Frequency: Occasional (HP:0040283). (ORPHA:91349)
- Heteronymous hemianopia (HP:0030517). Evidence: TAS. Frequency: Occasional (HP:0040283). (ORPHA:91349)
- Cerebrospinal fluid rhinorrhoea (HP:0030998): Drainage of cerebrospinal fluid through the nose. This can occur when there is a fistula between the dura and the skull base and discharge of cerebrospinal fluid (CSF) from the nose. Evidence: TAS. Frequency: Occasional (HP:0040283). (ORPHA:91349)
- Pituitary adenoma (HP:0002893): A benign epithelial tumor derived from intrinsic cells of the adenohypophysis (anterior pituitary). Evidence: TAS. Frequency: Very frequent (HP:0040281). (ORPHA:91349)
- Male hypogonadism (HP:0000026): Decreased functionality of the male gonad, i.e., of the testis, with reduced spermatogenesis or testosterone synthesis. Evidence: TAS. Frequency: Frequent (HP:0040282). (ORPHA:91349)
- Hypogonadotropic hypogonadism (HP:0000044): Hypogonadotropic hypogonadism is characterized by reduced function of the gonads (testes in males or ovaries in females) and results from the absence of the gonadal stimulating pituitary hormones: follicle stimulating hormone (FSH) and luteinizing hormone (LH). Evidence: TAS. Frequency: Frequent (HP:0040282). (ORPHA:91349)
- Female hypogonadism (HP:0000134): Decreased functionality of the female gonads, i.e., of the ovary. Evidence: TAS. Frequency: Frequent (HP:0040282). (ORPHA:91349)
- Hypogonadism (HP:0000135): A decreased functionality of the gonad. Evidence: TAS. Frequency: Frequent (HP:0040282). (ORPHA:91349)
- Abnormality of the menstrual cycle (HP:0000140): An abnormality of the ovulation cycle. Evidence: TAS. Frequency: Frequent (HP:0040282). (ORPHA:91349)
- Progressive visual loss (HP:0000529): A reduction of previously attained ability to see. Evidence: TAS. Frequency: Frequent (HP:0040282). (ORPHA:91349)
- Impotence (HP:0000802): Inability to develop or maintain an erection of the penis. Evidence: TAS. Frequency: Frequent (HP:0040282). (ORPHA:91349)
- Decreased response to growth hormone stimulation test (HP:0000824): Insufficient responses to growth hormone (GH) provocation tests. GH deficiency is defined as a serum peak GH concentration less than 10 ng/mL on provocation with a combination of at least two separate stimulation tests. Evidence: TAS. Frequency: Frequent (HP:0040282). (ORPHA:91349)
- Anterior hypopituitarism (HP:0000830): A condition of reduced function of the anterior pituitary gland characterized by decreased secretion of one or more of the pituitary hormones growth hormone, thyroid-stimulating hormone, adrenocorticotropic hormone, prolactin, luteinizing hormone, and follicle-stimulating hormone. Evidence: TAS. Frequency: Frequent (HP:0040282). (ORPHA:91349)
- Increased circulating gonadotropin level (HP:0000837): Overproduction of gonadotropins (FSH, LH) by the anterior pituitary gland. Evidence: TAS. Frequency: Frequent (HP:0040282). (ORPHA:91349)
- Adrenal insufficiency (HP:0000846): Insufficient production of steroid hormones (primarily cortisol) by the adrenal glands. Evidence: TAS. Frequency: Frequent (HP:0040282). (ORPHA:91349)
- Irregular menstruation (HP:0000858): Abnormally high variation in the amount of time between periods. Evidence: TAS. Frequency: Frequent (HP:0040282). (ORPHA:91349)
- Decreased fertility in females (HP:0000868). Evidence: TAS. Frequency: Frequent (HP:0040282). (ORPHA:91349)
- Pallor (HP:0000980): Abnormally pale skin. Evidence: TAS. Frequency: Frequent (HP:0040282). (ORPHA:91349)
- Vomiting (HP:0002013): Forceful ejection of the contents of the stomach through the mouth by means of a series of involuntary spasmic contractions. Evidence: TAS. Frequency: Frequent (HP:0040282). (ORPHA:91349)
- Nausea and vomiting (HP:0002017): Nausea is a commonly encountered symptom that has been defined as an unpleasant painless subjective feeling that one will imminently vomit. Vomiting has been defined as the forceful expulsion of the contents of the stomach, duodenum, or jejunum through the oral cavity. While nausea and vomiting are often thought to exist on a temporal continuum, this is not always the case. There are situations when severe nausea may be present without emesis and less frequently, when emesis may be present without preceding nausea. Evidence: TAS. Frequency: Frequent (HP:0040282). (ORPHA:91349)
- Headache (HP:0002315): Cephalgia, or pain sensed in various parts of the head, not confined to the area of distribution of any nerve. Evidence: TAS. Frequency: Frequent (HP:0040282). (ORPHA:91349)
- Hypotension (HP:0002615): Low Blood Pressure, vascular hypotension. Evidence: TAS. Frequency: Frequent (HP:0040282). (ORPHA:91349)
- Decreased circulating ACTH concentration (HP:0002920): The concentration of corticotropin, also known as adrenocorticotropic hormone (ACTH), is below the lower limit of normal in the blood circulation. Evidence: TAS. Frequency: Frequent (HP:0040282). (ORPHA:91349)
- Easy fatigability (HP:0003388): Increased susceptibility to fatigue. Evidence: TAS. Frequency: Frequent (HP:0040282). (ORPHA:91349)
- Secondary growth hormone deficiency (HP:0008240). Evidence: TAS. Frequency: Frequent (HP:0040282). (ORPHA:91349)
- Pituitary hypothyroidism (HP:0008245): A type of hypothyroidism that results from a defect in thyroid-stimulating hormone secretion. Evidence: TAS. Frequency: Frequent (HP:0040282). (ORPHA:91349)
- Increased intraabdominal fat (HP:0008993): An abnormal increase in the amount of intraabdominal fat tissue. Evidence: TAS. Frequency: Frequent (HP:0040282). (ORPHA:91349)
- Anemia of inadequate production (HP:0010972): A kind of anemia characterized by inadequate production of erythrocytes. Evidence: TAS. Frequency: Frequent (HP:0040282). (ORPHA:91349)
- Abnormal hair quantity (HP:0011362): An abnormal amount of hair. Evidence: TAS. Frequency: Frequent (HP:0040282). (ORPHA:91349)
- Central adrenal insufficiency (HP:0011734): A form of adrenal insufficiency related to a lack of ACTH, which leads to a decrease in the production of cortisol by the adrenal glands. Aldosterone production is not usually affected. Evidence: TAS. Frequency: Frequent (HP:0040282). (ORPHA:91349)
- Adrenocorticotropin deficient adrenal insufficiency (HP:0011735): Adrenal insufficiency secondary to a defect in ACTH production. Evidence: TAS. Frequency: Frequent (HP:0040282). (ORPHA:91349)
- Adrenocorticotropic hormone deficiency (HP:0011748): A reduced ability to secrete adrenocorticotropic hormone (ACTH), a hormone that stimulates the adrenal cortex to secrete of glucocorticoids such as cortisol. Evidence: TAS. Frequency: Frequent (HP:0040282). (ORPHA:91349)
- Abnormal muscle physiology (HP:0011804): A functional abnormality of a skeletal muscle. Evidence: TAS. Frequency: Frequent (HP:0040282). (ORPHA:91349)
- Decreased fertility in males (HP:0012041). Evidence: TAS. Frequency: Frequent (HP:0040282). (ORPHA:91349)
- Fatigue (HP:0012378): A subjective feeling of tiredness characterized by a lack of energy and motivation. Evidence: TAS. Frequency: Frequent (HP:0040282). (ORPHA:91349)
- Abnormal pituitary gland morphology (HP:0012503): An anomaly of the pituitary gland. Evidence: TAS. Frequency: Frequent (HP:0040282). (ORPHA:91349)
- Decreased female libido (HP:0030018): Diminished sexual desire in female. Evidence: TAS. Frequency: Frequent (HP:0040282). (ORPHA:91349)
- Bitemporal hemianopia (HP:0030521). Evidence: TAS. Frequency: Frequent (HP:0040282). (ORPHA:91349)
- Hypopituitarism (HP:0040075). Evidence: TAS. Frequency: Frequent (HP:0040282). (ORPHA:91349)
- Erectile dysfunction (HP:0100639): A multidimensional but common male sexual dysfunction that involves an alteration in any of the components of the erectile response, including organic, relational and psychological. Evidence: TAS. Frequency: Frequent (HP:0040282). (ORPHA:91349)
- Macroorchidism (HP:0000053): The presence of abnormally large testes. Evidence: TAS. Frequency: Occasional (HP:0040283). (ORPHA:91349)
These phenotypes are associated with the disease Non-functioning pituitary adenoma (ORPHA:91349).